Phenotypes associated with the disease AMP deaminase deficiency, erythrocytic (OMIM:612874, an entry in Online Mendelian Inheritance in Man):
- Autosomal recessive inheritance (HP:0000007, a Human Phenotype Ontology term): A mode of inheritance that is observed for traits related to a gene encoded on one of the autosomes (i.e., the human chromosomes 1-22) in which a trait manifests in individuals with two pathogenic alleles, either homozygotes (two copies of the same mutant allele) or compound heterozygotes (whereby each copy of a gene has a distinct mutant allele). Evidence: TAS. (OMIM:612874)